- Coarse facial features (HP:0000280): Absence of fine and sharp appearance of brows, nose, lips, mouth, and chin, usually because of rounded and heavy features or thickened skin with or without thickening of subcutaneous and bony tissues. Evidence: TAS. Frequency: Frequent (HP:0040282). (ORPHA:85319)
- Intellectual disability (HP:0001249): The term intellectual disability or intellectual developmental disorder is used to describe significantly sub-average intellectual and adaptive functioning based on clinical assessment and as measured by individually administered, appropriately normed, standardized and validated tests of intellectual functioning and adaptive behavior, with onset during the developmental period from infancy through adolescence. Evidence: TAS. Frequency: Frequent (HP:0040282). (ORPHA:85319)
- Seizure (HP:0001250): A seizure is an intermittent abnormality of nervous system physiology characterized by a transient occurrence of signs and/or symptoms due to abnormal excessive or synchronous neuronal activity in the brain. Evidence: TAS. Frequency: Frequent (HP:0040282). (ORPHA:85319)
- Global developmental delay (HP:0001263): A delay in the achievement of motor or mental milestones in the domains of development of a child, including motor skills, speech and language, cognitive skills, and social and emotional skills. This term should only be used to describe children younger than five years of age. Evidence: TAS. Frequency: Frequent (HP:0040282). (ORPHA:85319)
- Generalized hypotonia (HP:0001290): Generalized muscular hypotonia (abnormally low muscle tone). Evidence: TAS. Frequency: Frequent (HP:0040282). (ORPHA:85319)
- Multiple joint contractures (HP:0002828). Evidence: TAS. Frequency: Frequent (HP:0040282). (ORPHA:85319)
- Progressive flexion contractures (HP:0005876): Progressively worsening joint contractures. Evidence: TAS. Frequency: Frequent (HP:0040282). (ORPHA:85319)
- Feeding difficulties in infancy (HP:0008872): Impaired feeding performance of an infant as manifested by difficulties such as weak and ineffective sucking, brief bursts of sucking, and falling asleep during sucking. There may be difficulties with chewing or maintaining attention. Evidence: TAS. Frequency: Frequent (HP:0040282). (ORPHA:85319)
These phenotypes are associated with the disease X-linked intellectual disability-epilepsy-progressive joint contractures-dysmorphism syndrome (ORPHA:85319).